- Bilateral tonic-clonic seizure (HP:0002069): A bilateral tonic-clonic seizure is a seizure defined by a tonic (bilateral increased tone, lasting seconds to minutes) and then a clonic (bilateral sustained rhythmic jerking) phase. Evidence: PCS. Frequency: 2/12. (PMID:32097630)
- Focal impaired awareness seizure (HP:0002384): Focal impaired awareness seizure (or focal seizure with impaired or lost awareness) is a type of focal-onset seizure characterized by some degree (which may be partial) of impairment of the person's awareness of themselves or their surroundings at any point during the seizure. Evidence: PCS. Frequency: 6/12. (PMID:32097630)
- Generalized non-motor (absence) seizure (HP:0002121): A generalized non-motor (absence) seizure is a type of a type of dialeptic seizure that is of electrographically generalized onset. It is a generalized seizure characterized by an interruption of activities, a blank stare, and usually the person will be unresponsive when spoken to. Any ictal motor phenomena are minor in comparison to these non-motor features. Evidence: PCS. Frequency: 1/12. (PMID:32097630)
- Myoclonic seizure (HP:0032794): A myoclonic seizure is a type of motor seizure characterized by sudden, brief (<100 ms) involuntary single or multiple contraction of muscles or muscle groups of variable topography (axial, proximal limb, distal). Myoclonus is less regularly repetitive and less sustained than is clonus. Evidence: PCS. Frequency: 2/12. (PMID:32097630)
- Agyria (HP:0031882): A congenital abnormality of the cerebral hemisphere characterized by lack of gyrations (convolutions) of the cerebral cortex. Agyria is defined as cortical regions lacking gyration with sulci great than 3 cm apart and cerebral cortex thicker than 5 mm. Evidence: PCS. Frequency: 2/13. (PMID:32097630)
- Posterior predominant subcortical band heterotopia (HP:0032411): Longitudinal bands of gray matter located deep to the cerebral cortex and separated from it by a thin layer of normal appearing white matter visible along the occipital cortex. Evidence: PCS. Frequency: 9/13. (PMID:32097630)
- Suicidal ideation (HP:0031589): Frequent thoughts about or preoccupation with killing oneself. Evidence: PCS. Frequency: 2/13. (PMID:32097630)
- Depression (HP:0000716): Frequently experiencing feelings of being down, miserable, and/or hopeless; struggling to recover from these moods; having a pessimistic outlook on the future; feeling a pervasive sense of shame; having a low self-worth; experiencing thoughts of suicide and engaging in suicidal behavior. Evidence: PCS. Frequency: 1/13. (PMID:32097630)
- Cerebral visual impairment (HP:0100704): A form of loss of vision caused by damage to the visual cortex rather than a defect in the eye. Evidence: PCS. Frequency: 2/13. (PMID:32097630)
- Aggressive behavior (HP:0000718): Behavior or an act aimed at harming a person, animal, or physical property (e.g., acts of physical violence; shouting, swearing, and using harsh language; slashing someone's tires). Evidence: PCS. Frequency: 2/13. (PMID:32097630)
- Bipolar affective disorder (HP:0007302): Bipolar disorder is an illness of mood characterized by alternating episodes of elevated and depressed moods, which are interspersed with euthymic periods. Evidence: PCS. Frequency: 1/13. (PMID:32097630)
- Pachygyria (HP:0001302): Pachygyria is a malformation of cortical development with abnormally wide gyri with sulci 1,5-3 cm apart and abnormally thick cortex measuring more than 5 mm (radiological definition). See also neuropathological definitions for 2-, 3-, and 4-layered lissencephaly. Evidence: PCS. Frequency: 3/13. (PMID:32097630)
- Intellectual disability (HP:0001249): The term intellectual disability or intellectual developmental disorder is used to describe significantly sub-average intellectual and adaptive functioning based on clinical assessment and as measured by individually administered, appropriately normed, standardized and validated tests of intellectual functioning and adaptive behavior, with onset during the developmental period from infancy through adolescence. Evidence: PCS. Frequency: 6/13. (PMID:32097630)
- Torticollis (HP:0000473): Involuntary contractions of the neck musculature resulting in an abnormal posture of or abnormal movements of the head. Evidence: PCS. Frequency: 1/13. (PMID:32097630)
- EEG abnormality (HP:0002353): Abnormality observed by electroencephalogram (EEG), which is used to record of the brain's spontaneous electrical activity from multiple electrodes placed on the scalp. Evidence: PCS. Frequency: 11/11. (PMID:32097630)
- Febrile seizure (within the age range of 3 months to 6 years) (HP:0002373): A febrile seizure is any type of seizure (most often a generalized tonic-clonic seizure) occurring with fever (at least 38 degrees Celsius) but in the absence of central nervous system infection, severe metabolic disturbance or other alternative precipitant in children between the ages of 3 months and 6 years. Evidence: PCS. Frequency: 2/12. (PMID:32097630)
- Generalized-onset seizure (HP:0002197): A generalized-onset seizure is a type of seizure originating at some point within, and rapidly engaging, bilaterally distributed networks. The networks may include cortical and subcortical structures but not necessarily the entire cortex. Evidence: PCS. Frequency: 2/12. (PMID:32097630)
- Atonic seizure (HP:0010819): Atonic seizure is a type of motor seizure characterized by a sudden loss or diminution of muscle tone without apparent preceding myoclonic or tonic event lasting about 1 to 2 seconds, involving head, trunk, jaw, or limb musculature. Evidence: PCS. Frequency: 4/12. (PMID:32097630)
- Visual agnosia (HP:0030222): The condition is known as visual agnosia, which refers to the inability to recognize objects that are visually presented, even though the individual may have normal visual field, acuity, color vision, brightness discrimination, language, and memory. Evidence: PCS. Frequency: 1/13. (PMID:32097630)
- Global developmental delay (HP:0001263): A delay in the achievement of motor or mental milestones in the domains of development of a child, including motor skills, speech and language, cognitive skills, and social and emotional skills. This term should only be used to describe children younger than five years of age. Evidence: PCS. Frequency: 5/13. (PMID:32097630)
- Mild microcephaly (HP:0040196): Decreased occipito-frontal (head) circumference (OFC). For the microcephaly OFC must be between -3 SD and -2 SD compared to appropriate, age matched, normal standards (i.e. -3 SD <= OFC < -2 SD). Evidence: PCS. Frequency: 1/13. (PMID:32097630)
- Atypical absence seizure (HP:0007270): An atypical absence seizure is a type of generalized non-motor (absence) seizure characterized by interruption of ongoing activities and reduced responsiveness. In comparison to a typical absence seizure, changes in tone may be more pronounced, onset and/or cessation may be less abrupt, and the duration of the ictus and post-ictal recovery may be longer. Although not always available, an EEG often demonstrates slow (<3 Hz), irregular, generalized spike-wave activity. Evidence: PCS. Frequency: 1/12. (PMID:32097630)
- Tonic seizure (HP:0032792): A tonic seizure is a type of motor seizure characterized by unilateral or bilateral limb stiffening or elevation, often with neck stiffening. Evidence: PCS. Frequency: 3/12. (PMID:32097630)
- Autistic behavior (HP:0000729): Persistent deficits in social interaction and communication and interaction as well as a markedly restricted repertoire of activity and interest as well as repetitive patterns of behavior. Evidence: PCS. Frequency: 1/13. (PMID:32097630)
- Hypodontia (HP:0000668): The absence of five or less teeth from the normal series by a failure to develop. Evidence: PCS. Frequency: 1/13. (PMID:32097630)
- Bilateral tonic-clonic seizure with focal onset (HP:0007334): A bilateral tonic-clonic seizure with focal onset is a focal-onset seizure which progresses into a bilateral tonic-clonic phase. Evidence: PCS. Frequency: 1/12. (PMID:32097630)
- Auditory hallucination (HP:0008765): Perception of sounds without auditory stimulus. Evidence: PCS. Frequency: 1/13. (PMID:32097630)
- Autosomal dominant inheritance (HP:0000006): A mode of inheritance that is observed for traits related to a gene encoded on one of the autosomes (i.e., the human chromosomes 1-22) in which a trait manifests in heterozygotes. In the context of medical genetics, an autosomal dominant disorder is caused when a single copy of the mutant allele is present. Males and females are affected equally, and can both transmit the disorder with a risk of 50% for each child of inheriting the mutant allele. Evidence: PCS. (PMID:32097630)
These phenotypes are associated with the disease lissencephaly 10 (OMIM:618873).